Phenotypes associated with the disease ovalocytosis, hereditary hemolytic, with defective erythropoiesis (OMIM:166910):
- Elliptocytosis (HP:0004445): The presence of elliptical, cigar-shaped erythrocytes on peripheral blood smear. Evidence: TAS. (OMIM:166910)
- Hemolytic anemia (HP:0001878): A type of anemia caused by premature destruction of red blood cells (hemolysis). Evidence: TAS. (OMIM:166910)
- Anemia of inadequate production (HP:0010972): A kind of anemia characterized by inadequate production of erythrocytes. Evidence: TAS. (OMIM:166910)
- Autosomal dominant inheritance (HP:0000006): A mode of inheritance that is observed for traits related to a gene encoded on one of the autosomes (i.e., the human chromosomes 1-22) in which a trait manifests in heterozygotes. In the context of medical genetics, an autosomal dominant disorder is caused when a single copy of the mutant allele is present. Males and females are affected equally, and can both transmit the disorder with a risk of 50% for each child of inheriting the mutant allele. Evidence: TAS. (OMIM:166910)